Phenotypes associated with the disease orofaciodigital syndrome XI (OMIM:612913):
- Kyphoscoliosis (HP:0002751): An abnormal curvature of the spine in both a coronal (lateral) and sagittal (back-to-front) plane. Evidence: IEA. (OMIM:612913)
- Postaxial polydactyly (HP:0100259): A form of polydactyly in which the extra digit or digits are localized on the side of the fifth finger or fifth toe. Evidence: PCS. Frequency: 1/1. Onset: Congenital onset (HP:0003577). (PMID:25876182)
- Cleft palate (HP:0000175): Cleft palate is a developmental defect of the palate resulting from a failure of fusion of the palatine processes and manifesting as a separation of the roof of the mouth (soft and hard palate). Evidence: PCS. Frequency: 1/1. (PMID:7531942)
- Downslanted palpebral fissures (HP:0000494): The palpebral fissure inclination is more than two standard deviations below the mean. Evidence: PCS. Frequency: 1/1. (PMID:25876182)
- Wide nasal bridge (HP:0000431): Increased breadth of the nasal bridge (and with it, the nasal root). Evidence: PCS. Frequency: 1/1. (PMID:25876182)
- Hypoplasia of the odontoid process (HP:0003311): Developmental hypoplasia of the dens of the axis. Evidence: PCS. Frequency: 1/1. (PMID:25876182)
- Seizure (HP:0001250): A seizure is an intermittent abnormality of nervous system physiology characterized by a transient occurrence of signs and/or symptoms due to abnormal excessive or synchronous neuronal activity in the brain. Evidence: PCS. Frequency: 1/1. Onset: Infantile onset (HP:0003593). (PMID:25876182)
- Gastroesophageal reflux (HP:0002020): A condition in which the stomach contents leak backwards from the stomach into the esophagus through the lower esophageal sphincter. Evidence: PCS. Frequency: 1/1. (PMID:25876182)
- Bulbous nose (HP:0000414): Increased volume and globular shape of the anteroinferior aspect of the nose. Evidence: PCS. Frequency: 1/1. (PMID:25876182)
- Sporadic (HP:0003745): Cases of the disease in question occur without a previous family history, i.e., as isolated cases without being transmitted from a parent and without other siblings being affected. Evidence: IEA. (OMIM:612913)
- Intellectual disability (HP:0001249): The term intellectual disability or intellectual developmental disorder is used to describe significantly sub-average intellectual and adaptive functioning based on clinical assessment and as measured by individually administered, appropriately normed, standardized and validated tests of intellectual functioning and adaptive behavior, with onset during the developmental period from infancy through adolescence. Evidence: PCS. (PMID:7531942)